- Hyporeflexia (HP:0001265): Reduction of neurologic reflexes such as the knee-jerk reaction. Evidence: IEA. (OMIM:618247)
- Cerebral atrophy (HP:0002059): Atrophy (wasting, decrease in size of cells or tissue) affecting the cerebrum. Evidence: PCS. Frequency: 1/1. (PMID:22114105)
- Dysphagia (HP:0002015): Difficulty in swallowing. Evidence: IEA. (OMIM:618247)
- EEG abnormality (HP:0002353): Abnormality observed by electroencephalogram (EEG), which is used to record of the brain's spontaneous electrical activity from multiple electrodes placed on the scalp. Evidence: IEA. (OMIM:618247)
- Hearing impairment (HP:0000365): A decreased magnitude of the sensory perception of sound. Evidence: PCS. Frequency: 1/1. (PMID:22114105)
- Choreoathetosis (HP:0001266): Involuntary movements characterized by both athetosis (inability to sustain muscles in a fixed position) and chorea (widespread jerky arrhythmic movements). Evidence: PCS. Frequency: 1/1. (PMID:22114105)
- Dystonia (HP:0001332): An abnormally increased muscular tone that causes fixed abnormal postures. There is a slow, intermittent twisting motion that leads to exaggerated turning and posture of the extremities and trunk. Evidence: PCS. Frequency: 1/1. (PMID:22114105)
- Cerebellar atrophy (HP:0001272): Cerebellar atrophy is defined as a cerebellum with initially normal structures, in a posterior fossa with normal size, which displays enlarged fissures (interfolial spaces) in comparison to the foliae secondary to loss of tissue. Cerebellar atrophy implies irreversible loss of tissue and result from an ongoing progressive disease until a final stage is reached or a single injury, e.g. an intoxication or infectious event. Evidence: PCS. Frequency: 1/1. (PMID:22114105)
- Distal amyotrophy (HP:0003693): Muscular atrophy affecting muscles in the distal portions of the extremities. Evidence: IEA. (OMIM:618247)
- Dysarthria (HP:0001260): Dysarthric speech is a general description referring to a neurological speech disorder characterized by poor articulation. Depending on the involved neurological structures, dysarthria may be further classified as spastic, flaccid, ataxic, hyperkinetic and hypokinetic, or mixed. Evidence: IEA. (OMIM:618247)
- Increased circulating lactate concentration (HP:0002151): Abnormally increased level of blood lactate (2-hydroxypropanoic acid). Lactate is produced from pyruvate by lactate dehydrogenase during normal metabolism. The terms lactate and lactic acid are often used interchangeably but lactate (the component measured in blood) is strictly a weak base whereas lactic acid is the corresponding acid. Lactic acidosis is often used clinically to describe elevated lactate but should be reserved for cases where there is a corresponding acidosis (pH below 7.35). Evidence: PCS. Frequency: 1/1. (PMID:22114105)
- Elevated lactate:pyruvate ratio (HP:0032653): An abnormal increase in the molar ratio of lactate to pyruvate in the blood circulation. Evidence: PCS. Frequency: 1/1. (PMID:22114105)
- Respiratory insufficiency (HP:0002093). Evidence: PCS. Frequency: 1/1. (PMID:22114105)
- Decreased activity of mitochondrial complex I (HP:0011923): A reduction in the activity of the mitochondrial respiratory chain complex I, which is part of the electron transport chain in mitochondria. Evidence: PCS. Frequency: 1/1. (PMID:22114105)
- Reduced cerebral white matter volume (HP:0034295): An abnormally low volume of the white matter of the brain. Evidence: PCS. Frequency: 1/1. (PMID:22114105)
- Limb hypertonia (HP:0002509). Evidence: IEA. (OMIM:618247)
- Autosomal recessive inheritance (HP:0000007): A mode of inheritance that is observed for traits related to a gene encoded on one of the autosomes (i.e., the human chromosomes 1-22) in which a trait manifests in individuals with two pathogenic alleles, either homozygotes (two copies of the same mutant allele) or compound heterozygotes (whereby each copy of a gene has a distinct mutant allele). Evidence: PCS. (PMID:22114105)
- Lacticaciduria (HP:0003648): An increased concentration of lactic acid in the urine. Evidence: PCS. Frequency: 1/1. (PMID:22114105)
- Rod-cone dystrophy (HP:0000510): An inherited retinal disease subtype in which the rod photoreceptors appear to be more severely affected than the cone photoreceptors. Typical presentation is with nyctalopia (due to rod dysfunction) followed by loss of mid-peripheral field of vision, which gradually extends and leaves many patients with a small central island of vision due to the preservation of macular cones. Evidence: PCS. Frequency: 1/1. (PMID:22114105)
- Metabolic acidosis (HP:0001942): Metabolic acidosis (MA) is characterized by a fall in blood pH due to a reduction of serum bicarbonate concentration. This can occur as a result of either the accumulation of acids (high anion gap MA) or the loss of bicarbonate from the gastrointestinal tract or the kidney (hyperchloremic MA). By definition, MA is not due to a respirary cause. Evidence: PCS. Frequency: 1/1. (PMID:22114105)
- Neonatal onset (HP:0003623): Onset of signs or symptoms of disease within the first 28 days of life. Evidence: PCS. Frequency: 1/1. (PMID:22114105)
These phenotypes are associated with the disease mitochondrial complex I deficiency, nuclear type 26 (OMIM:618247).